- Seizure (HP:0001250): A seizure is an intermittent abnormality of nervous system physiology characterized by a transient occurrence of signs and/or symptoms due to abnormal excessive or synchronous neuronal activity in the brain. Evidence: IEA. (OMIM:617116)
- Typified by incomplete penetrance (HP:0003829): Description of conditions in which not all individuals with a given genotype exhibit the disease. Penetrance is the proportion that develop disease given a lifespan of 80 years. Evidence: TAS. (OMIM:617116)
- Focal cortical dysplasia (HP:0032046): A type of malformation of cortical development that primarily affects areas of neocortex. It can be identified on conventional magnetic resonance imaging as focal cortical thickening, abnormal gyration, and blurring between gray and white matter, often associated with clusters of heterotopic neurons. Evidence: PCS. Frequency: 1/2. Onset: Childhood onset (HP:0011463). (PMID:27173016)
- Autosomal dominant inheritance (HP:0000006): A mode of inheritance that is observed for traits related to a gene encoded on one of the autosomes (i.e., the human chromosomes 1-22) in which a trait manifests in heterozygotes. In the context of medical genetics, an autosomal dominant disorder is caused when a single copy of the mutant allele is present. Males and females are affected equally, and can both transmit the disorder with a risk of 50% for each child of inheriting the mutant allele. Evidence: TAS. (OMIM:617116)
These phenotypes are associated with the disease epilepsy, familial focal, with variable foci 2 (OMIM:617116).